- Hypopigmentation of the skin (HP:0001010): A reduction of skin color related to a decrease in melanin production and deposition. Evidence: IEA. (OMIM:179500)
- Autosomal dominant inheritance (HP:0000006): A mode of inheritance that is observed for traits related to a gene encoded on one of the autosomes (i.e., the human chromosomes 1-22) in which a trait manifests in heterozygotes. In the context of medical genetics, an autosomal dominant disorder is caused when a single copy of the mutant allele is present. Males and females are affected equally, and can both transmit the disorder with a risk of 50% for each child of inheriting the mutant allele. Evidence: IEA. (OMIM:179500)
These phenotypes are associated with the disease raindrop hypopigmentation (OMIM:179500).